- Congenital onset (HP:0003577): A phenotypic abnormality that is present at birth. Evidence: PCS. (PMID:17851452)
- Autosomal recessive inheritance (HP:0000007): A mode of inheritance that is observed for traits related to a gene encoded on one of the autosomes (i.e., the human chromosomes 1-22) in which a trait manifests in individuals with two pathogenic alleles, either homozygotes (two copies of the same mutant allele) or compound heterozygotes (whereby each copy of a gene has a distinct mutant allele). Evidence: PCS. (PMID:17851452)
- Profound sensorineural hearing impairment (HP:0011476): Complete loss of hearing related to a sensorineural defect. Evidence: PCS. Onset: Congenital onset (HP:0003577). (PMID:17851452)
These phenotypes are associated with the disease autosomal recessive nonsyndromic hearing loss 3 (OMIM:600316).